Phenotypes associated with the disease chromosome 2p12-p11.2 deletion syndrome (OMIM:613564):
- Sloping forehead (HP:0000340): Inclination of the anterior surface of the forehead from the vertical more than two standard deviations above the mean (objective); or apparently excessive posterior sloping of the forehead in a lateral view. Evidence: PCS. Frequency: 1/1. (PMID:8151644)
- Congenital onset (HP:0003577): A phenotypic abnormality that is present at birth. Evidence: PCS. Frequency: 1/1. (PMID:8151644)
- Anteverted nares (HP:0000463): Anteriorly-facing nostrils viewed with the head in the Frankfurt horizontal and the eyes of the observer level with the eyes of the subject. This gives the appearance of an upturned nose (upturned nasal tip). Evidence: PCS. Frequency: 1/1. (PMID:8151644)
- Gait ataxia (HP:0002066): A type of ataxia characterized by the impairment of the ability to coordinate the movements required for normal walking. Gait ataxia is characteirzed by a wide-based staggering gait with a tendency to fall. Evidence: PCS. Frequency: 1/1. (PMID:8411037)
- Narrow mouth (HP:0000160): Distance between the commissures of the mouth more than 2 SD below the mean. Alternatively, an apparently decreased width of the oral aperture (subjective). Evidence: PCS. Frequency: 1/1. (PMID:8151644)
- Blepharophimosis (HP:0000581): A fixed reduction in the vertical distance between the upper and lower eyelids with short palpebral fissures. Evidence: PCS. Frequency: 1/1. (PMID:8411037)
- Infantile onset (HP:0003593): Onset of signs or symptoms of disease between 28 days to one year of life. Evidence: PCS. Frequency: 1/1. (PMID:8411037)
- Prominent nasal tip (HP:0005274). Evidence: PCS. Frequency: 1/1. (PMID:8151644)
- Aggressive behavior (HP:0000718): Behavior or an act aimed at harming a person, animal, or physical property (e.g., acts of physical violence; shouting, swearing, and using harsh language; slashing someone's tires). Evidence: PCS. Frequency: 1/1. (PMID:8411037)
- Short distal phalanx of finger (HP:0009882): Short distance from the end of the finger to the most distal interphalangeal crease or the distal interphalangeal joint flexion point. That is, hypoplasia of one or more of the distal phalanx of finger. Evidence: PCS. Frequency: 1/1. (PMID:8151644)
- Large fontanelles (HP:0000239): In newborns, the two frontal bones, two parietal bones, and one occipital bone are joined by fibrous sutures, which form a small posterior fontanelle, and a larger, diamond-shaped anterior fontanelle. These regions allow for the skull to pass the birth canal and for later growth. The fontanelles gradually ossify, whereby the posterior fontanelle usually closes by eight weeks and the anterior fontanelle by the 9th to 16th month of age. Large fontanelles are diagnosed if the fontanelles are larger than age-dependent norms. Evidence: PCS. Frequency: 1/1. (PMID:8151644)
- Reduced visual acuity (HP:0007663). Evidence: PCS. Frequency: 1/1. (PMID:8411037)
- Thin upper lip vermilion (HP:0000219): Height of the vermilion of the upper lip in the midline more than 2 SD below the mean. Alternatively, an apparently reduced height of the vermilion of the upper lip in the frontal view (subjective). Evidence: PCS. Frequency: 1/1. (PMID:8151644)
- Postnatal growth retardation (HP:0008897): Slow or limited growth after birth. Evidence: PCS. Frequency: 1/1. (PMID:8151644)
- High palate (HP:0000218): Height of the palate more than 2 SD above the mean (objective) or palatal height at the level of the first permanent molar more than twice the height of the teeth (subjective). Evidence: PCS. Frequency: 1/1. (PMID:8411037)
- Lower limb hypertonia (HP:0006895). Evidence: PCS. Frequency: 1/1. (PMID:8411037)
- Contiguous gene syndrome (HP:0001466): A syndrome caused by the effects of abnormality (typically a deletion or duplication) of 2 or more adjacent genes. Evidence: PCS. (PMID:8411037)
- Posteriorly rotated ears (HP:0000358): A type of abnormal location of the ears in which the position of the ears is characterized by posterior rotation (the superior part of the ears is rotated towards the back of the head, and the inferior part of the ears towards the front). Evidence: PCS. Frequency: 1/1. (PMID:8151644)
- Highly arched eyebrow (HP:0002553): Increased height of the central portion of the eyebrow, forming a crescent, semicircular, or inverted U shape. Evidence: PCS. Frequency: 1/1. (PMID:8151644)
- Downslanted palpebral fissures (HP:0000494): The palpebral fissure inclination is more than two standard deviations below the mean. Evidence: PCS. Frequency: 1/1. (PMID:8151644)
- Wide nasal bridge (HP:0000431): Increased breadth of the nasal bridge (and with it, the nasal root). Evidence: PCS. Frequency: 1/1. (PMID:8151644)
- Feeding difficulties (HP:0011968): Impaired ability to eat related to problems gathering food and getting ready to suck, chew, or swallow it. Evidence: PCS. Frequency: 2/2. (PMID:8151644;PMID:8411037)
- Global developmental delay (HP:0001263): A delay in the achievement of motor or mental milestones in the domains of development of a child, including motor skills, speech and language, cognitive skills, and social and emotional skills. This term should only be used to describe children younger than five years of age. Evidence: PCS. Frequency: 1/1. (PMID:8411037)
- Short neck (HP:0000470): Diminished length of the neck. Evidence: PCS. Frequency: 1/1. (PMID:8151644)
- Clinodactyly of the 4th finger (HP:0040025). Evidence: PCS. Frequency: 1/1. (PMID:8411037)
- Telecanthus (HP:0000506): Distance between the inner canthi more than two standard deviations above the mean (objective); or, apparently increased distance between the inner canthi. Evidence: PCS. Frequency: 1/1. (PMID:8151644)
- Ptosis (HP:0000508): The upper eyelid margin is positioned 3 mm or more lower than usual and covers the superior portion of the iris (objective); or, the upper lid margin obscures at least part of the pupil (subjective). Evidence: PCS. Frequency: 1/1. (PMID:8151644)
- Coronal hypospadias (HP:0008743): A mild form of hypospadias in which the urethra opens just under the corona glandis, that is, where the head of the penis meets the shaft. Evidence: PCS. Frequency: 1/1. (PMID:8151644)
- Short 5th finger (HP:0009237): Hypoplasia (congenital reduction in size) of the fifth finger, also known as the little finger. Evidence: PCS. Frequency: 1/1. (PMID:8411037)
- Conductive hearing impairment (HP:0000405): An abnormality of vibrational conductance of sound to the inner ear leading to impairment of sensory perception of sound. Evidence: PCS. Frequency: 1/1. (PMID:8151644)
- Intrauterine growth retardation (HP:0001511): An abnormal restriction of fetal growth with fetal weight below the tenth percentile for gestational age. Evidence: PCS. Frequency: 1/1. (PMID:8151644)
- Thrombocytopenia (HP:0001873): A reduction in the number of circulating thrombocytes. Evidence: PCS. Frequency: 1/1. (PMID:8411037)
- Short philtrum (HP:0000322): Distance between nasal base and midline upper lip vermilion border more than 2 SD below the mean. Alternatively, an apparently decreased distance between nasal base and midline upper lip vermilion border. Evidence: PCS. Frequency: 1/1. (PMID:8151644)
- Micrognathia (HP:0000347): Developmental hypoplasia of the mandible. Evidence: PCS. Frequency: 1/1. (PMID:8411037)
- Low-set ears (HP:0000369): Upper insertion of the ear to the scalp below an imaginary horizontal line drawn between the inner canthi of the eye and extending posteriorly to the ear. Evidence: PCS. Frequency: 2/2. (PMID:8151644;PMID:8411037)
- Cryptorchidism (HP:0000028): Testis in inguinal canal. That is, absence of one or both testes from the scrotum owing to failure of the testis or testes to descend through the inguinal canal to the scrotum. Evidence: PCS. Frequency: 1/1. (PMID:8151644)